- Spicular pigmentation of the retina (HP:0007737): Pigment migration into the retina in a bone-spicule configuration (resembling the nucleated cells within the lacuna of bone). Evidence: IEA. (OMIM:180210)
- Nyctalopia (HP:0000662): Inability to see well at night or in poor light. Evidence: IEA. (OMIM:180210)
- Blindness (HP:0000618): Blindness is the condition of lacking visual perception defined as a profound reduction in visual perception. On the 6m visual acuity scale, blindness is defined as less than 3/60. On the 20ft visual acuity scale, blindness is defined as less than 20/400. On the decimal visual acuity scale, blindness is defined as less than 0.05. Blindness is typically characterized by a visual field of no greater than 10 degrees in radius around central fixation. Evidence: TAS. Onset: Late onset (HP:0003584). (OMIM:180210)
- Pigmentary retinopathy (HP:0000580): An abnormality of the retina characterized by pigment deposition. It is typically associated with migration and proliferation of macrophages or retinal pigment epithelial cells into the retina; melanin from these cells causes the pigmentary changes. Pigmentary retinopathy is a common final pathway of many retinal conditions and is often associated with visual loss. Evidence: TAS. (OMIM:180210)
- Retinopathy (HP:0000488): Any noninflammatory disease of the retina. This nonspecific term is retained here because of its wide use in the literature, but if possible new annotations should indicate the precise type of retinal abnormality. Evidence: IEA. (OMIM:180210)
- Attenuation of retinal blood vessels (HP:0007843): Narrowing of the retinal blood vessels, both arterioles and venules. Evidence: IEA. (OMIM:180210)
- Autosomal dominant inheritance (HP:0000006): A mode of inheritance that is observed for traits related to a gene encoded on one of the autosomes (i.e., the human chromosomes 1-22) in which a trait manifests in heterozygotes. In the context of medical genetics, an autosomal dominant disorder is caused when a single copy of the mutant allele is present. Males and females are affected equally, and can both transmit the disorder with a risk of 50% for each child of inheriting the mutant allele. Evidence: IEA. (OMIM:180210)
- Retinal dystrophy (HP:0000556): Retinal dystrophy is an abnormality of the retina associated with a hereditary process. Retinal dystrophies are defined by their predominantly monogenic inheritance and they are frequently associated with loss or dysfunction of photoreceptor cells as a primary or secondary event. Evidence: TAS. (OMIM:180210)
- Retinal atrophy (HP:0001105): A nonspecific term denoting wasting, especially as a result of degeneration, of the retinal pigment epithelium (RPE) and neurosensory retinal cells. Evidence: IEA. (OMIM:180210)
These phenotypes are associated with the disease dominant pericentral pigmentary retinopathy (OMIM:180210).